- Bilateral tonic-clonic seizure (HP:0002069): A bilateral tonic-clonic seizure is a seizure defined by a tonic (bilateral increased tone, lasting seconds to minutes) and then a clonic (bilateral sustained rhythmic jerking) phase. Evidence: TAS. (OMIM:614847)
- Variable expressivity (HP:0003828): A variable severity of phenotypic features. Evidence: TAS. (OMIM:614847)
- Typified by incomplete penetrance (HP:0003829): Description of conditions in which not all individuals with a given genotype exhibit the disease. Penetrance is the proportion that develop disease given a lifespan of 80 years. Evidence: TAS. (OMIM:614847)
- Autosomal dominant inheritance (HP:0000006): A mode of inheritance that is observed for traits related to a gene encoded on one of the autosomes (i.e., the human chromosomes 1-22) in which a trait manifests in heterozygotes. In the context of medical genetics, an autosomal dominant disorder is caused when a single copy of the mutant allele is present. Males and females are affected equally, and can both transmit the disorder with a risk of 50% for each child of inheriting the mutant allele. Evidence: TAS. (OMIM:614847)
- Intellectual disability (HP:0001249): The term intellectual disability or intellectual developmental disorder is used to describe significantly sub-average intellectual and adaptive functioning based on clinical assessment and as measured by individually administered, appropriately normed, standardized and validated tests of intellectual functioning and adaptive behavior, with onset during the developmental period from infancy through adolescence. Evidence: TAS. Frequency: Occasional (HP:0040283). (OMIM:614847)
These phenotypes are associated with the disease epilepsy, idiopathic generalized, susceptibility to, 12 (OMIM:614847).